- Febrile seizure (within the age range of 3 months to 6 years) (HP:0002373): A febrile seizure is any type of seizure (most often a generalized tonic-clonic seizure) occurring with fever (at least 38 degrees Celsius) but in the absence of central nervous system infection, severe metabolic disturbance or other alternative precipitant in children between the ages of 3 months and 6 years. Evidence: TAS. (OMIM:300454)
- X-linked recessive inheritance (HP:0001419): A mode of inheritance that is observed for recessive traits related to a gene encoded on the X chromosome. In the context of medical genetics, X-linked recessive disorders manifest in males (who have one copy of the X chromosome and are thus hemizygotes), but generally not in female heterozygotes who have one mutant and one normal allele. Evidence: TAS. (OMIM:300454)
- Hyperactivity (HP:0000752): Hyperactivity is a condition characterized by constant and unusually high levels of activity, even in situations where it is deemed inappropriate. Evidence: TAS. (OMIM:300454)
- Intellectual disability (HP:0001249): The term intellectual disability or intellectual developmental disorder is used to describe significantly sub-average intellectual and adaptive functioning based on clinical assessment and as measured by individually administered, appropriately normed, standardized and validated tests of intellectual functioning and adaptive behavior, with onset during the developmental period from infancy through adolescence. Evidence: TAS. (OMIM:300454)
These phenotypes are associated with the disease intellectual disability, X-linked 77 (OMIM:300454).